- Abnormality of the dentition (HP:0000164): Any abnormality of the teeth. Evidence: IEA. (OMIM:183400)
- Abnormal lower lip morphology (HP:0000178): An abnormality of the lower lip. Evidence: TAS. (OMIM:183400)
- Narrow maxilla (HP:0002010). Evidence: IEA. (OMIM:183400)
- Lower lip pit (HP:0000196): Depression located on the vermilion of the lower lip, usually paramedian. Evidence: TAS. (OMIM:183400)
- Autosomal dominant inheritance (HP:0000006): A mode of inheritance that is observed for traits related to a gene encoded on one of the autosomes (i.e., the human chromosomes 1-22) in which a trait manifests in heterozygotes. In the context of medical genetics, an autosomal dominant disorder is caused when a single copy of the mutant allele is present. Males and females are affected equally, and can both transmit the disorder with a risk of 50% for each child of inheriting the mutant allele. Evidence: IEA. (OMIM:183400)
These phenotypes are associated with the disease split lower lip (OMIM:183400).